- Late onset (HP:0003584): A type of adult onset with onset of symptoms after the age of 60 years. Evidence: TAS. (OMIM:125853)
- Increased waist to hip ratio (HP:0031819): Increased waist-to-hip ratio (WHR) is a measurement above the average for the dimensionless ratio of the circumference of the waist to that of the hips. WHR is calculated as waist measurement divided by hip measurement. Evidence: TAS. (OMIM:125853)
- Insulin resistance (HP:0000855): Increased resistance towards insulin, that is, diminished effectiveness of insulin in reducing blood glucose levels. Evidence: TAS. (OMIM:125853)
- Type II diabetes mellitus (HP:0005978): A type of diabetes mellitus initially characterized by insulin resistance and hyperinsulinemia and subsequently by glucose interolerance and hyperglycemia. Evidence: TAS. (OMIM:125853)
- Autosomal dominant inheritance (HP:0000006): A mode of inheritance that is observed for traits related to a gene encoded on one of the autosomes (i.e., the human chromosomes 1-22) in which a trait manifests in heterozygotes. In the context of medical genetics, an autosomal dominant disorder is caused when a single copy of the mutant allele is present. Males and females are affected equally, and can both transmit the disorder with a risk of 50% for each child of inheriting the mutant allele. Evidence: TAS. (OMIM:125853)
These phenotypes are associated with the disease type 2 diabetes mellitus (OMIM:125853).